- Autosomal dominant inheritance (HP:0000006): A mode of inheritance that is observed for traits related to a gene encoded on one of the autosomes (i.e., the human chromosomes 1-22) in which a trait manifests in heterozygotes. In the context of medical genetics, an autosomal dominant disorder is caused when a single copy of the mutant allele is present. Males and females are affected equally, and can both transmit the disorder with a risk of 50% for each child of inheriting the mutant allele. Evidence: TAS. (OMIM:190400)
- Trigeminal neuralgia (HP:0100661): A neuropathic disorder characterized by episodes of intense pain in the face, originating from the trigeminal nerve. One, two, or all three branches of the nerve may be affected. Evidence: TAS. (OMIM:190400)
These phenotypes are associated with the disease trigeminal neuralgia (OMIM:190400).